Phenotypes associated with the disease hereditary progressive chorea without dementia (OMIM:118700):
- Gait disturbance (HP:0001288): The term gait disturbance can refer to any disruption of the ability to walk. Evidence: IEA. (OMIM:118700)
- Dysarthria (HP:0001260): Dysarthric speech is a general description referring to a neurological speech disorder characterized by poor articulation. Depending on the involved neurological structures, dysarthria may be further classified as spastic, flaccid, ataxic, hyperkinetic and hypokinetic, or mixed. Evidence: TAS. Frequency: Occasional (HP:0040283). (OMIM:118700)
- Dementia (HP:0000726): A loss of global cognitive ability of sufficient amount to interfere with normal social or occupational function. Dementia represents a loss of previously present cognitive abilities, generally in adults, and can affect memory, thinking, language, judgment, and behavior. Evidence: PCS. Frequency: 0/4. (PMID:12891678)
- Childhood onset (HP:0011463): Onset of disease at the age of between 1 and 5 years. Evidence: PCS. Frequency: 2/4. (PMID:12891678)
- Anxiety (HP:0000739): Intense feelings of nervousness, tension, or panic often arise in response to interpersonal stresses. There is worry about the negative effects of past unpleasant experiences and future negative possibilities. Individuals may feel fearful, apprehensive, or threatened by uncertainty, and they may also have fears of falling apart or losing control. Evidence: IEA. (OMIM:118700)
- Infantile onset (HP:0003593): Onset of signs or symptoms of disease between 28 days to one year of life. Evidence: PCS. Frequency: 2/4. (PMID:12891678)
- Chorea (HP:0002072): Chorea (Greek for 'dance') refers to widespread arrhythmic involuntary movements of a forcible, jerky and restless fashion. It is a random-appearing sequence of one or more discrete involuntary movements or movement fragments. Movements appear random because of variability in timing, duration or location. Each movement may have a distinct start and end. However, movements may be strung together and thus may appear to flow randomly from one muscle group to another. Chorea can involve the trunk, neck, face, tongue, and extremities. Evidence: PCS. Frequency: 4/4. (PMID:12891678)
- Motor delay (HP:0001270): A type of Developmental delay characterized by a delay in acquiring motor skills. Evidence: PCS. Frequency: 4/4. (PMID:12891678)
- Frequent falls (HP:0002359). Evidence: PCS. Frequency: 1/4. (PMID:12891678)
- Autosomal dominant inheritance (HP:0000006): A mode of inheritance that is observed for traits related to a gene encoded on one of the autosomes (i.e., the human chromosomes 1-22) in which a trait manifests in heterozygotes. In the context of medical genetics, an autosomal dominant disorder is caused when a single copy of the mutant allele is present. Males and females are affected equally, and can both transmit the disorder with a risk of 50% for each child of inheriting the mutant allele. Evidence: PCS. (PMID:11971878)